- Recurrent infections (HP:0002719): Increased susceptibility to infections as manifested by repeated bouts of infection. Evidence: IEA. (OMIM:191150)
- Autosomal dominant inheritance (HP:0000006): A mode of inheritance that is observed for traits related to a gene encoded on one of the autosomes (i.e., the human chromosomes 1-22) in which a trait manifests in heterozygotes. In the context of medical genetics, an autosomal dominant disorder is caused when a single copy of the mutant allele is present. Males and females are affected equally, and can both transmit the disorder with a risk of 50% for each child of inheriting the mutant allele. Evidence: IEA. (OMIM:191150)
- Abnormality of the spleen (HP:0001743): An abnormality of the spleen. Evidence: IEA. (OMIM:191150)
These phenotypes are associated with the disease Tuftsin deficiency (OMIM:191150).